Phenotypes associated with the disease spermatogenic failure 49 (OMIM:619144):
- Coiled sperm flagella (HP:0032560): Sperm cells whose flagella are twisted (coiled). Evidence: PCS. Frequency: 5/5. (PMID:32791035)
- Male infertility (HP:0003251). Evidence: PCS. Frequency: 5/5. (PMID:32791035)
- Adult onset (HP:0003581): Onset of disease manifestations in adulthood, defined here as at the age of 16 years or later. Evidence: PCS. (PMID:32791035)
- Autosomal recessive inheritance (HP:0000007): A mode of inheritance that is observed for traits related to a gene encoded on one of the autosomes (i.e., the human chromosomes 1-22) in which a trait manifests in individuals with two pathogenic alleles, either homozygotes (two copies of the same mutant allele) or compound heterozygotes (whereby each copy of a gene has a distinct mutant allele). Evidence: PCS. (PMID:32791035)
- Reduced sperm motility (HP:0012207): An abnormal reduction in the mobility of ejaculated sperm. Evidence: PCS. Frequency: 5/5. (PMID:32791035)
- Absent sperm flagella (HP:0032558): Sperm cells lacking flagella. Evidence: PCS. Frequency: 5/5. (PMID:32791035)
- Short sperm flagella (HP:0032559): Sperm cells with abnormally short flagella. Evidence: PCS. Frequency: 5/5. (PMID:32791035)